Phenotypes associated with the disease tooth agenesis, selective, 10 (OMIM:620173):
- Narrow forehead (HP:0000341): Width of the forehead or distance between the frontotemporales is more than two standard deviations below the mean (objective); or apparently narrow intertemporal region (subjective). Evidence: PCS. Frequency: 1/4. (PMID:30046887)
- Microcephaly (HP:0000252): Head circumference below 2 standard deviations below the mean for age and gender. Evidence: PCS. Frequency: 1/4. (PMID:30046887)
- Autosomal recessive inheritance (HP:0000007): A mode of inheritance that is observed for traits related to a gene encoded on one of the autosomes (i.e., the human chromosomes 1-22) in which a trait manifests in individuals with two pathogenic alleles, either homozygotes (two copies of the same mutant allele) or compound heterozygotes (whereby each copy of a gene has a distinct mutant allele). Evidence: PCS. (PMID:30046887)
- High palate (HP:0000218): Height of the palate more than 2 SD above the mean (objective) or palatal height at the level of the first permanent molar more than twice the height of the teeth (subjective). Evidence: PCS. Frequency: 1/4. (PMID:30046887)
- Low-set ears (HP:0000369): Upper insertion of the ear to the scalp below an imaginary horizontal line drawn between the inner canthi of the eye and extending posteriorly to the ear. Evidence: PCS. Frequency: 1/4. (PMID:30046887)
- Oligodontia (HP:0000677): The absence of six or more teeth from the normal series by a failure to develop. Evidence: PCS. Frequency: 4/4. (PMID:30046887)